- Hypertension (HP:0000822): The presence of chronic increased pressure in the systemic arterial system. Evidence: TAS. Frequency: Obligate (HP:0040280). (ORPHA:231580)
- Decreased circulating renin concentration (HP:0003351): An decreased level of renin in the blood. Evidence: TAS. Frequency: Obligate (HP:0040280). (ORPHA:231580)
- Glucocortocoid-insensitive primary hyperaldosteronism (HP:0011740): A form of primary hyperaldosteronism in which the overproduction of aldosterone cannot be suppressed by the administration of dexamethasone or similar glucocorticoids. Evidence: TAS. Frequency: Obligate (HP:0040280). (ORPHA:231580)
- Hypokalemia (HP:0002900): The concentration of potassium(1+) in the blood circulation is below the lower limit of normal. Evidence: TAS. Frequency: Frequent (HP:0040282). (ORPHA:231580)
- Increased urinary potassium (HP:0003081): An increased concentration of potassium(1+) in the urine. Evidence: TAS. Frequency: Frequent (HP:0040282). (ORPHA:231580)
- Adrenal hyperplasia (HP:0008221): Enlargement of the adrenal gland. Evidence: TAS. Frequency: Frequent (HP:0040282). (ORPHA:231580)
- Metabolic alkalosis (HP:0200114): Metabolic alkalosis is defined as a disease state where the pH is elevated to greater than 7.45 secondary to some metabolic process. Evidence: TAS. Frequency: Frequent (HP:0040282). (ORPHA:231580)
- Tinnitus (HP:0000360): Tinnitus is an auditory perception that can be described as the experience of sound, in the ear or in the head, in the absence of external acoustic stimulation. Evidence: TAS. Frequency: Occasional (HP:0040283). (ORPHA:231580)
- Epistaxis (HP:0000421): Epistaxis, or nosebleed, refers to a hemorrhage localized in the nose. Evidence: TAS. Frequency: Occasional (HP:0040283). (ORPHA:231580)
- Muscle weakness (HP:0001324): Reduced strength of muscles. Evidence: TAS. Frequency: Occasional (HP:0040283). (ORPHA:231580)
- Polydipsia (HP:0001959): Excessive thirst manifested by excessive fluid intake. Evidence: TAS. Frequency: Occasional (HP:0040283). (ORPHA:231580)
- Palpitations (HP:0001962): A sensation that the heart is pounding or racing, which is a non-specific sign but may be a manifestation of arrhythmia. Evidence: TAS. Frequency: Occasional (HP:0040283). (ORPHA:231580)
- Nausea (HP:0002018): A sensation of unease in the stomach together with an urge to vomit. Evidence: TAS. Frequency: Occasional (HP:0040283). (ORPHA:231580)
- Headache (HP:0002315): Cephalgia, or pain sensed in various parts of the head, not confined to the area of distribution of any nerve. Evidence: TAS. Frequency: Occasional (HP:0040283). (ORPHA:231580)
- Muscle spasm (HP:0003394): Sudden and involuntary contractions of one or more muscles. Evidence: TAS. Frequency: Occasional (HP:0040283). (ORPHA:231580)
These phenotypes are associated with the disease Primary unilateral adrenal hyperplasia (ORPHA:231580).